Phenotypes associated with the disease Urachal diverticulum (ORPHA:431347):
- Recurrent urinary tract infections (HP:0000010): Repeated infections of the urinary tract. Evidence: TAS. Frequency: Frequent (HP:0040282). (ORPHA:431347)
- Hematuria (HP:0000790): The presence of blood in the urine. Hematuria may be gross hematuria (visible to the naked eye) or microscopic hematuria (detected by dipstick or microscopic examination of the urine). Evidence: TAS. Frequency: Occasional (HP:0040283). (ORPHA:431347)
- Abdominal pain (HP:0002027): An unpleasant sensation characterized by physical discomfort (such as pricking, throbbing, or aching) and perceived to originate in the abdomen. Evidence: TAS. Frequency: Occasional (HP:0040283). (ORPHA:431347)
- Abdominal mass (HP:0031500): An abnormal enlargement or swelling in the abdomen. Evidence: TAS. Frequency: Occasional (HP:0040283). (ORPHA:431347)
- Pelvic mass (HP:0031501): An abnormal enlargement or swelling in the pelvic region. Evidence: TAS. Frequency: Occasional (HP:0040283). (ORPHA:431347)
- Pelvic pain (HP:0034267): Pain perceived in the area of the pelvis, the lower part of the abdomen located between the hip bones. Evidence: TAS. Frequency: Occasional (HP:0040283). (ORPHA:431347)
- Bladder outlet obstruction (HP:0041047): A compression or resistance upon the bladder outflow channel at any location from the bladder neck to urethral meatus, which usually causes lower urinary tract symptoms (LUTS). Evidence: TAS. Frequency: Occasional (HP:0040283). (ORPHA:431347)
- Bladder neoplasm (HP:0009725): The presence of a neoplasm of the urinary bladder. Evidence: TAS. Frequency: Very rare (HP:0040284). (ORPHA:431347)